- Obstructive sleep apnea (HP:0002870): Obstructive Sleep Apnea is a condition characterized by the obstruction of the airway and pauses in breathing during sleep, which occur multiple times throughout the night. It is related to the relaxation of muscle tone that typically happens during sleep, leading to a partial collapse of the soft tissues in the airway and causing airflow obstruction. Evidence: TAS. (OMIM:107650)
- Focal impaired awareness seizure (HP:0002384): Focal impaired awareness seizure (or focal seizure with impaired or lost awareness) is a type of focal-onset seizure characterized by some degree (which may be partial) of impairment of the person's awareness of themselves or their surroundings at any point during the seizure. Evidence: TAS. (OMIM:107650)
- Snoring (HP:0025267): Deep, noisy breathing during sleep, accompanied by hoarse or harsh sounds, is caused by the vibration of respiratory structures, especially the soft palate. This vibration results in sound due to obstructed air movement during breathing while sleeping. Evidence: TAS. (OMIM:107650)
- Excessive daytime somnolence (HP:0001262): A state of abnormally strong desire for sleep during the daytime. Evidence: TAS. (OMIM:107650)
- Anosmia (HP:0000458): An inability to perceive odors. This is a general term describing inability to smell arising in any part of the process of smelling from absorption of odorants into the nasal mucous overlying the olfactory epithelium, diffusion to the cilia, binding to olfactory receptor sites, generation of action potentials in olfactory neurons, and perception of a smell. Evidence: TAS. (OMIM:107650)
- Autosomal dominant inheritance (HP:0000006): A mode of inheritance that is observed for traits related to a gene encoded on one of the autosomes (i.e., the human chromosomes 1-22) in which a trait manifests in heterozygotes. In the context of medical genetics, an autosomal dominant disorder is caused when a single copy of the mutant allele is present. Males and females are affected equally, and can both transmit the disorder with a risk of 50% for each child of inheriting the mutant allele. Evidence: TAS. (OMIM:107650)
These phenotypes are associated with the disease obstructive sleep apnea syndrome (OMIM:107650).